Phenotypes associated with the disease Herpes simplex virus encephalitis (ORPHA:1930):
- EEG abnormality (HP:0002353): Abnormality observed by electroencephalogram (EEG), which is used to record of the brain's spontaneous electrical activity from multiple electrodes placed on the scalp. Evidence: TAS. Frequency: Very frequent (HP:0040281). (ORPHA:1930)
- Reduced consciousness (HP:0004372): Abnormally diminished level of attention, responsiveness, or wakefulness. Evidence: TAS. Frequency: Very frequent (HP:0040281). (ORPHA:1930)
- Abnormal brain morphology (HP:0012443): A structural abnormality of the brain, which has as its parts the forebrain, midbrain, and hindbrain. Evidence: TAS. Frequency: Very frequent (HP:0040281). (ORPHA:1930)
- CSF lymphocytic pleiocytosis (HP:0200149): An increased lymphocyte count in the cerebrospinal fluid. Evidence: TAS. Frequency: Very frequent (HP:0040281). (ORPHA:1930)
- Seizure (HP:0001250): A seizure is an intermittent abnormality of nervous system physiology characterized by a transient occurrence of signs and/or symptoms due to abnormal excessive or synchronous neuronal activity in the brain. Evidence: TAS. Frequency: Frequent (HP:0040282). (ORPHA:1930)
- Fever (HP:0001945): Body temperature elevated above the normal range. Evidence: TAS. Frequency: Frequent (HP:0040282). (ORPHA:1930)
- Increased total leukocyte count (HP:0001974): An abnormal increase in the number of leukocytes in the blood. Evidence: TAS. Frequency: Frequent (HP:0040282). (ORPHA:1930)
- Nausea and vomiting (HP:0002017): Nausea is a commonly encountered symptom that has been defined as an unpleasant painless subjective feeling that one will imminently vomit. Vomiting has been defined as the forceful expulsion of the contents of the stomach, duodenum, or jejunum through the oral cavity. While nausea and vomiting are often thought to exist on a temporal continuum, this is not always the case. There are situations when severe nausea may be present without emesis and less frequently, when emesis may be present without preceding nausea. Evidence: TAS. Frequency: Frequent (HP:0040282). (ORPHA:1930)
- Abnormal speech pattern (HP:0002167): An abnormality in the sound (volume) or cadence (rate) of speech. Evidence: TAS. Frequency: Frequent (HP:0040282). (ORPHA:1930)
- Headache (HP:0002315): Cephalgia, or pain sensed in various parts of the head, not confined to the area of distribution of any nerve. Evidence: TAS. Frequency: Frequent (HP:0040282). (ORPHA:1930)
- Hyponatremia (HP:0002902): The concentration of sodium in the blood circulation is below the lower limit of normal. Evidence: TAS. Frequency: Frequent (HP:0040282). (ORPHA:1930)
- Increased CSF protein concentration (HP:0002922): Increased concentration of protein in the cerebrospinal fluid. Evidence: TAS. Frequency: Frequent (HP:0040282). (ORPHA:1930)
- Respiratory failure requiring assisted ventilation (HP:0004887): A state of respiratory distress that requires a life saving intervention in the form of gaining airway access and instituting positive pressure ventilation. Evidence: TAS. Frequency: Frequent (HP:0040282). (ORPHA:1930)
- Loss of consciousness (HP:0007185): Loss of awareness of oneself or one's surroundings, involving (i) a loss of normal motor control is evident as flaccidity or stiffness, either of which can be accompanied by jerking movements, and postural control is lost so that patients fall if they are in an upright position; (ii) normal responsiveness is lost; and (iii) the patient experiences amnesia for the event. Loss of consciousness my be transitory (e.g., syncope) or prolonged. Evidence: TAS. Frequency: Frequent (HP:0040282). (ORPHA:1930)
- Increased total neutrophil count (HP:0011897): Abnormal increase of absolute number of neutrophils in the blood, per microliter, compared to a reference range for a given sex and age-group. Evidence: TAS. Frequency: Frequent (HP:0040282). (ORPHA:1930)
- Fatigue (HP:0012378): A subjective feeling of tiredness characterized by a lack of energy and motivation. Evidence: TAS. Frequency: Frequent (HP:0040282). (ORPHA:1930)
- Nuchal rigidity (HP:0031179): Resistance of the extensor muscles of the neck to being bent forwards (i.e., impaired neck flexion) as a result of muscle spasm of the extensor muscles of the neck. Nuchal rigidity is not a fixed rigidity. Nuchal rigidity has been used as a bedside test for meningism, although its sensitivity for this purpose has been debated. Evidence: TAS. Frequency: Frequent (HP:0040282). (ORPHA:1930)
- Coma (HP:0001259): The complete absence of wakefulness and consciousness, which is evident through a lack of response to any form of external stimuli. Evidence: TAS. Frequency: Occasional (HP:0040283). (ORPHA:1930)
- Excessive daytime somnolence (HP:0001262): A state of abnormally strong desire for sleep during the daytime. Evidence: TAS. Frequency: Occasional (HP:0040283). (ORPHA:1930)
- Hyperreflexia (HP:0001347): Hyperreflexia is the presence of hyperactive stretch reflexes of the muscles. Evidence: TAS. Frequency: Occasional (HP:0040283). (ORPHA:1930)
- Status epilepticus (HP:0002133): Status epilepticus is a type of prolonged seizure resulting either from the failure of the mechanisms responsible for seizure termination or from the initiation of mechanisms which lead to abnormally prolonged seizures (after time point t1). It is a condition that can have long-term consequences (after time point t2), including neuronal death, neuronal injury, and alteration of neuronal networks, depending on the type and duration of seizures. Evidence: TAS. Frequency: Occasional (HP:0040283). (ORPHA:1930)
- Cerebral edema (HP:0002181): Abnormal accumulation of fluid in the brain. Evidence: TAS. Frequency: Occasional (HP:0040283). (ORPHA:1930)
- Focal aware seizure (HP:0002349): A type of focal-onset seizure in which awareness is preserved. Awareness during a seizure is defined as the patient being fully aware of themself and their environment throughout the seizure, even if immobile. Evidence: TAS. Frequency: Occasional (HP:0040283). (ORPHA:1930)
- Focal impaired awareness seizure (HP:0002384): Focal impaired awareness seizure (or focal seizure with impaired or lost awareness) is a type of focal-onset seizure characterized by some degree (which may be partial) of impairment of the person's awareness of themselves or their surroundings at any point during the seizure. Evidence: TAS. Frequency: Occasional (HP:0040283). (ORPHA:1930)
- Immunodeficiency (HP:0002721): Failure of the immune system to protect the body adequately from infection, due to the absence or insufficiency of some component process or substance. Evidence: TAS. Frequency: Occasional (HP:0040283). (ORPHA:1930)
- Functional motor deficit (HP:0004302). Evidence: TAS. Frequency: Occasional (HP:0040283). (ORPHA:1930)
- Elevated circulating C-reactive protein concentration (HP:0011227): The concentration of C-reactive protein in the blood circulation is above the upper limit of normal. Evidence: TAS. Frequency: Occasional (HP:0040283). (ORPHA:1930)
- Hypoglycorrhachia (HP:0011972): Abnormally low glucose concentration in the cerebrospinal fluid. Evidence: TAS. Frequency: Occasional (HP:0040283). (ORPHA:1930)
- Chills (HP:0025143): A sudden sensation of feeling cold. Evidence: TAS. Frequency: Occasional (HP:0040283). (ORPHA:1930)
- Addictive alcohol use (HP:0030955): An addictive behavior is defined as drinking excessive amounts of alcohol over a prolonged period of time, having difficulty in reducing the amount of alcohol consumed, strongly desiring alcohol, and experiencing withdrawal symptoms when not drinking alcohol. Evidence: TAS. Frequency: Occasional (HP:0040283). (ORPHA:1930)